Phenotypes associated with the disease fallot complex-intellectual disability-growth delay syndrome (OMIM:601127):
- Abnormality of the face (HP:0000271): An abnormality of the face. Evidence: IEA. (OMIM:601127)
- Failure to thrive (HP:0001508): Failure to thrive (FTT) refers to a child whose physical growth is substantially below the norm. Evidence: IEA. (OMIM:601127)
- Ventricular septal defect (HP:0001629): A hole between the two bottom chambers (ventricles) of the heart. The defect is centered around the most superior aspect of the ventricular septum. Evidence: IEA. (OMIM:601127)
- Double outlet right ventricle (HP:0001719): Double outlet right ventricle (DORV) is a type of ventriculoarterial connection in which both great vessels arise entirely or predominantly from the right ventricle. Evidence: IEA. (OMIM:601127)
- Tetralogy of Fallot (HP:0001636): A congenital cardiac malformation comprising pulmonary stenosis, overriding aorta, ventricular septum defect, and right ventricular hypertrophy. The diagnosis of TOF is made if at least three of the four above mentioned features are present. Evidence: IEA. (OMIM:601127)
- Autosomal recessive inheritance (HP:0000007): A mode of inheritance that is observed for traits related to a gene encoded on one of the autosomes (i.e., the human chromosomes 1-22) in which a trait manifests in individuals with two pathogenic alleles, either homozygotes (two copies of the same mutant allele) or compound heterozygotes (whereby each copy of a gene has a distinct mutant allele). Evidence: IEA. (OMIM:601127)
- Pulmonic stenosis (HP:0001642): A narrowing of the right ventricular outflow tract that can occur at the pulmonary valve (valvular stenosis), below the pulmonary valve (infundibular stenosis), or above the pulmonary valve (supravalvar stenosis). Evidence: IEA. (OMIM:601127)
- Intellectual disability (HP:0001249): The term intellectual disability or intellectual developmental disorder is used to describe significantly sub-average intellectual and adaptive functioning based on clinical assessment and as measured by individually administered, appropriately normed, standardized and validated tests of intellectual functioning and adaptive behavior, with onset during the developmental period from infancy through adolescence. Evidence: IEA. (OMIM:601127)